- Scarring (HP:0100699): A scar refers to a lesion in which wound, burn, or sore has not healed completely and fibrous connective tissue has developed. Evidence: PCS. Frequency: 1/1. (PMID:15744029)
- Monilethrix (HP:0032470): The hair shaft has a beaded appearance due to the presence of elliptical nodes that have the diameter of normal hair and are medullated, regularly separated by internodes that are narrow, devoid of medulla and are the site of fracture. Evidence: PCS. Frequency: 3/3. (PMID:15744029;PMID:25557232)
- Brittle hair (HP:0002299): Fragile, easily breakable hair, i.e., with reduced tensile strength. Evidence: PCS. Frequency: 3/3. (PMID:15744029;PMID:25557232)
- Alopecia (HP:0001596): A noncongenital process of hair loss, which may progress to partial or complete baldness. Evidence: PCS. Frequency: 2/2. (PMID:15744029;PMID:25557232)
- Alopecia of scalp (HP:0002293). Evidence: PCS. Frequency: 1/1. (PMID:25557232)
- Follicular hyperkeratosis (HP:0007502): A skin condition characterized by excessive development of keratin in hair follicles, resulting in rough, cone-shaped, elevated papules resulting from closure of hair follicles with a white plug of sebum. Evidence: PCS. Frequency: 2/2. (PMID:25557232)
- Autosomal dominant inheritance (HP:0000006): A mode of inheritance that is observed for traits related to a gene encoded on one of the autosomes (i.e., the human chromosomes 1-22) in which a trait manifests in heterozygotes. In the context of medical genetics, an autosomal dominant disorder is caused when a single copy of the mutant allele is present. Males and females are affected equally, and can both transmit the disorder with a risk of 50% for each child of inheriting the mutant allele. Evidence: PCS. (PMID:25557232)
These phenotypes are associated with the disease monilethrix-3 (OMIM:621170).